Phenotypes associated with the disease psoriasis 2 (OMIM:602723):
- Parakeratosis (HP:0001036): Abnormal formation of the keratinocytes of the epidermis characterized by persistence of nuclei, incomplete formation of keratin, and moistness and swelling of the keratinocytes. Evidence: PCS. (PMID:15689454)
- Scaling skin (HP:0040189): Refers to the loss of the outer layer of the epidermis in large, scale-like flakes. Evidence: PCS. (PMID:15689454)
- Epidermal acanthosis (HP:0025092): Diffuse hypertrophy or thickening of the stratum spinosum of the epidermis (prickle cell layer of the skin). Evidence: PCS. (PMID:15689454)
- Psoriasiform dermatitis (HP:0003765): A skin abnormality characterized by redness and irritation, with thick, red skin that displays flaky, silver-white patches (scales). Evidence: PCS. (PMID:22521418)
- Autosomal dominant inheritance (HP:0000006): A mode of inheritance that is observed for traits related to a gene encoded on one of the autosomes (i.e., the human chromosomes 1-22) in which a trait manifests in heterozygotes. In the context of medical genetics, an autosomal dominant disorder is caused when a single copy of the mutant allele is present. Males and females are affected equally, and can both transmit the disorder with a risk of 50% for each child of inheriting the mutant allele. Evidence: PCS. (PMID:22521418)
- Hyperkeratosis (HP:0000962): Hyperkeratosis is a histopathological term defining a thickened stratum corneum and may be present in many different skin conditions, with many possible overlaps. Hyperkeratosis refers to the increased thickness of the stratum corneum, the outer layer of the skin. Hyperkeratosis is subclassified as orthokeratotic or parakeratotic. Orthokeratotic hyperkeratosis refers to the thickening of the keratin layer with preserved keratinocyte maturation, while parakeratotic hyperkeratosis shows retained nuclei as a sign of delayed maturation of keratinocytes. Evidence: PCS. (PMID:15689454)